- Axial hypotonia (HP:0008936): Muscular hypotonia (abnormally low muscle tone) affecting the musculature of the trunk. Evidence: IEA. (OMIM:613861)
- Constriction of peripheral visual field (HP:0001133): An absolute or relative decrease in retinal sensitivity extending from edge (periphery) of the visual field in a concentric pattern. The visual field is the area that is perceived simultaneously by a fixating eye. Evidence: PCS. Frequency: 3/3. (PMID:21295283)
- Juvenile onset (HP:0003621): Onset of signs or symptoms of disease between the age of 5 and 15 years. Evidence: PCS. Frequency: 3/3. (PMID:21295283)
- Micropenis (HP:0000054): Abnormally small penis. At birth, the normal penis is about 3 cm (stretched length from pubic tubercle to tip of penis) with micropenis less than 2.0-2.5 cm. Evidence: IEA. (OMIM:613861)
- Nyctalopia (HP:0000662): Inability to see well at night or in poor light. Evidence: PCS. Frequency: 3/3. (PMID:21295283)
- Feeding difficulties (HP:0011968): Impaired ability to eat related to problems gathering food and getting ready to suck, chew, or swallow it. Evidence: IEA. (OMIM:613861)
- Seizure (HP:0001250): A seizure is an intermittent abnormality of nervous system physiology characterized by a transient occurrence of signs and/or symptoms due to abnormal excessive or synchronous neuronal activity in the brain. Evidence: IEA. (OMIM:613861)
- Renal insufficiency (HP:0000083): A reduction in the level of performance of the kidneys in areas of function comprising the concentration of urine, removal of wastes, the maintenance of electrolyte balance, homeostasis of blood pressure, and calcium metabolism. Evidence: IEA. (OMIM:613861)
- Hepatomegaly (HP:0002240): Abnormally increased size of the liver. Evidence: IEA. (OMIM:613861)
- Cystoid macular edema (HP:0011505): Cystoid thickening of the retina that takes place due to accumulation of extracellular fluid in the macula as a nonspecific response to blood-retinal barrier breakdown. Histological studies show that radially orientated cystoid spaces consisting of ophthalmoscopically clear fluid are often clinically detectable in the macula area. Evidence: TAS. Frequency: Occasional (HP:0040283). (OMIM:613861)
- Failure to thrive (HP:0001508): Failure to thrive (FTT) refers to a child whose physical growth is substantially below the norm. Evidence: IEA. (OMIM:613861)
- Sensorineural hearing impairment (HP:0000407): A type of hearing impairment in one or both ears related to an abnormal functionality of the cochlear nerve. Evidence: IEA. (OMIM:613861)
- Autosomal recessive inheritance (HP:0000007): A mode of inheritance that is observed for traits related to a gene encoded on one of the autosomes (i.e., the human chromosomes 1-22) in which a trait manifests in individuals with two pathogenic alleles, either homozygotes (two copies of the same mutant allele) or compound heterozygotes (whereby each copy of a gene has a distinct mutant allele). Evidence: PCS. (PMID:21295283)
- Reduced visual acuity (HP:0007663). Evidence: PCS. Frequency: 3/3. (PMID:21295283)
- Intrauterine growth retardation (HP:0001511): An abnormal restriction of fetal growth with fetal weight below the tenth percentile for gestational age. Evidence: IEA. (OMIM:613861)
- Rod-cone dystrophy (HP:0000510): An inherited retinal disease subtype in which the rod photoreceptors appear to be more severely affected than the cone photoreceptors. Typical presentation is with nyctalopia (due to rod dysfunction) followed by loss of mid-peripheral field of vision, which gradually extends and leaves many patients with a small central island of vision due to the preservation of macular cones. Evidence: IEA. Frequency: 3/3. (OMIM:613861)
- Elevated circulating hepatic transaminase concentration (HP:0002910): Elevations of the levels of SGOT and SGPT in the serum. SGOT (serum glutamic oxaloacetic transaminase) and SGPT (serum glutamic pyruvic transaminase) are transaminases primarily found in the liver and heart and are released into the bloodstream as the result of liver or heart damage. SGOT and SGPT are used clinically mainly as markers of liver damage. Evidence: IEA. (OMIM:613861)
- Spasticity (HP:0001257): A motor disorder characterized by a velocity-dependent increase in tonic stretch reflexes with increased muscle tone, exaggerated (hyperexcitable) tendon reflexes. Evidence: IEA. (OMIM:613861)
- Cryptorchidism (HP:0000028): Testis in inguinal canal. That is, absence of one or both testes from the scrotum owing to failure of the testis or testes to descend through the inguinal canal to the scrotum. Evidence: IEA. (OMIM:613861)
These phenotypes are associated with the disease retinitis pigmentosa 59 (OMIM:613861).